Phenotypes associated with the disease spermatogenic failure 94 (OMIM:620850):
- Multiflagellar spermatozoa (HP:0034309): Spermatozoa with multiple flagella attached to the sperm head. Evidence: PCS. Frequency: 2/2. (PMID:38441556)
- Reduced progressive sperm motility (HP:0034011): A reduced proportion of sperm that move in a straight line or large circles; alternatively, an increased proportion of sperm that move in tight circles or in some other non-linear fashion. Evidence: PCS. Frequency: 2/2. (PMID:38441556)
- Coiled sperm flagella (HP:0032560): Sperm cells whose flagella are twisted (coiled). Evidence: PCS. Frequency: 2/2. (PMID:38441556)
- Male infertility (HP:0003251). Evidence: PCS. Frequency: 2/2. (PMID:38441556)
- Young adult onset (HP:0011462): Onset of disease at the age of between 16 and 40 years. Evidence: PCS. Frequency: 2/2. (PMID:38441556)
- Reduced sperm motility (HP:0012207): An abnormal reduction in the mobility of ejaculated sperm. Evidence: PCS. Frequency: 2/2. (PMID:38441556)
- Autosomal recessive inheritance (HP:0000007): A mode of inheritance that is observed for traits related to a gene encoded on one of the autosomes (i.e., the human chromosomes 1-22) in which a trait manifests in individuals with two pathogenic alleles, either homozygotes (two copies of the same mutant allele) or compound heterozygotes (whereby each copy of a gene has a distinct mutant allele). Evidence: PCS. (PMID:38441556)
- Absent sperm flagella (HP:0032558): Sperm cells lacking flagella. Evidence: PCS. Frequency: 2/2. (PMID:38441556)
- Oligozoospermia (HP:0000798): Reduced count of spermatozoa in the semen, defined as a sperm count below 20 million per milliliter semen. Evidence: PCS. Frequency: 0/2. (PMID:38441556)
- Short sperm flagella (HP:0032559): Sperm cells with abnormally short flagella. Evidence: PCS. Frequency: 2/2. (PMID:38441556)